- Hydrocephalus (HP:0000238): Hydrocephalus is an active distension of the ventricular system of the brain resulting from inadequate passage of CSF from its point of production within the cerebral ventricles to its point of absorption into the systemic circulation. Evidence: TAS. Frequency: Obligate (HP:0040280). (ORPHA:73256)
- Intracranial cystic lesion (HP:0010576): A cystic lesion originating within the brain. Evidence: TAS. Frequency: Very frequent (HP:0040281). (ORPHA:73256)
- Abnormal cellular phenotype (HP:0025354): An anomaly of cellular morphology or physiology. Evidence: TAS. Frequency: Very frequent (HP:0040281). (ORPHA:73256)
- Abnormal lateral ventricle morphology (HP:0030047): A morphological anomaly of the lateral ventricle. Evidence: TAS. Frequency: Very frequent (HP:0040281). (ORPHA:73256)
- Abnormality of vision (HP:0000504): Abnormality of eyesight (visual perception). Evidence: TAS. Frequency: Frequent (HP:0040282). (ORPHA:73256)
- Depression (HP:0000716): Frequently experiencing feelings of being down, miserable, and/or hopeless; struggling to recover from these moods; having a pessimistic outlook on the future; feeling a pervasive sense of shame; having a low self-worth; experiencing thoughts of suicide and engaging in suicidal behavior. Evidence: TAS. Frequency: Frequent (HP:0040282). (ORPHA:73256)
- Ataxia (HP:0001251): Ataxia refers to impaired coordination of voluntary muscle movement. Cerebellar ataxia refers to ataxia due to dysfunction of the cerebellum. This causes a variety of elementary neurological deficits including asynergy (lack of coordination between muscles, limbs and joints), dysmetria (lack of ability to judge distances that can lead to under- or overshoot in grasping movements), and dysdiadochokinesia (inability to perform rapid movements requiring antagonizing muscle groups to be switched on and off repeatedly). Evidence: TAS. Frequency: Frequent (HP:0040282). (ORPHA:73256)
- Nausea and vomiting (HP:0002017): Nausea is a commonly encountered symptom that has been defined as an unpleasant painless subjective feeling that one will imminently vomit. Vomiting has been defined as the forceful expulsion of the contents of the stomach, duodenum, or jejunum through the oral cavity. While nausea and vomiting are often thought to exist on a temporal continuum, this is not always the case. There are situations when severe nausea may be present without emesis and less frequently, when emesis may be present without preceding nausea. Evidence: TAS. Frequency: Frequent (HP:0040282). (ORPHA:73256)
- Headache (HP:0002315): Cephalgia, or pain sensed in various parts of the head, not confined to the area of distribution of any nerve. Evidence: TAS. Frequency: Frequent (HP:0040282). (ORPHA:73256)
- Cerebral calcification (HP:0002514): The presence of calcium deposition within the cerebrum. Evidence: TAS. Frequency: Frequent (HP:0040282). (ORPHA:73256)
- Increased intracranial pressure (HP:0002516): An increase of the pressure inside the cranium (skull) and thereby in the brain tissue and cerebrospinal fluid. Evidence: TAS. Frequency: Frequent (HP:0040282). (ORPHA:73256)
- Decreased corneal reflex (HP:0008000): An abnormally reduced response to stimulation of the cornea (by touch, foreign body, blowing air). The corneal reflex (also known as the blink reflex, normally results in an involuntary blinking of the eyelids. Evidence: TAS. Frequency: Frequent (HP:0040282). (ORPHA:73256)
- Tinnitus (HP:0000360): Tinnitus is an auditory perception that can be described as the experience of sound, in the ear or in the head, in the absence of external acoustic stimulation. Evidence: TAS. Frequency: Occasional (HP:0040283). (ORPHA:73256)
- Lethargy (HP:0001254): A state of fatigue, either physical or mental slowness and sluggishness, with difficulties in initiating or performing simple tasks. Distinguished from apathy which implies indifference and a lack of desire or interest in the task. A person with lethargy may have the desire, but not the energy to engage in personal or socially relevant tasks. Evidence: TAS. Frequency: Occasional (HP:0040283). (ORPHA:73256)
- Coma (HP:0001259): The complete absence of wakefulness and consciousness, which is evident through a lack of response to any form of external stimuli. Evidence: TAS. Frequency: Occasional (HP:0040283). (ORPHA:73256)
- Postural instability (HP:0002172): A tendency to fall or the inability to keep oneself from falling; imbalance. The retropulsion test is widely regarded as the gold standard to evaluate postural instability, Use of the retropulsion test includes a rapid balance perturbation in the backward direction, and the number of balance correcting steps (or total absence thereof) is used to rate the degree of postural instability. Healthy subjects correct such perturbations with either one or two large steps, or without taking any steps, hinging rapidly at the hips while swinging the arms forward as a counterweight. In patients with balance impairment, balance correcting steps are often too small, forcing patients to take more than two steps. Taking three or more steps is generally considered to be abnormal, and taking more than five steps is regarded as being clearly abnormal. Markedly affected patients continue to step backward without ever regaining their balance and must be caught by the examiner (this would be called true retropulsion). Even more severely affected patients fail to correct entirely, and fall backward like a pushed toy soldier, without taking any corrective steps. Evidence: TAS. Frequency: Occasional (HP:0040283). (ORPHA:73256)
- Paresthesia (HP:0003401): Abnormal sensations such as tingling, pricking, or numbness of the skin with no apparent physical cause. Evidence: TAS. Frequency: Occasional (HP:0040283). (ORPHA:73256)
- Babinski sign (HP:0003487): Upturning of the big toe (and sometimes fanning of the other toes) in response to stimulation of the sole of the foot. If the Babinski sign is present it can indicate damage to the corticospinal tract. Evidence: TAS. Frequency: Occasional (HP:0040283). (ORPHA:73256)
- Pain insensitivity (HP:0007021): Inability to perceive painful stimuli. Evidence: TAS. Frequency: Occasional (HP:0040283). (ORPHA:73256)
These phenotypes are associated with the disease Central neurocytoma (ORPHA:73256).